Phenotypes associated with the disease Noonan syndrome (ORPHA:648):
- Joint hypermobility (HP:0001382): The capability that a joint (or a group of joints) has to move, passively and/or actively, beyond normal limits along physiological axes. Evidence: TAS. Frequency: Very frequent (HP:0040281). (ORPHA:648)
- Abnormal pulmonary valve morphology (HP:0001641): Any structural abnormality of the pulmonary valve. Evidence: TAS. Frequency: Frequent (HP:0040282). (ORPHA:648)
- Abnormality of the spleen (HP:0001743): An abnormality of the spleen. Evidence: TAS. Frequency: Frequent (HP:0040282). (ORPHA:648)
- Abnormal bleeding (HP:0001892): An abnormal susceptibility to bleeding, often referred to as a bleeding diathesis. A bleeding diathesis may be related to vascular, platelet and coagulation defects. Evidence: TAS. Frequency: Frequent (HP:0040282). (ORPHA:648)
- Abnormality of coagulation (HP:0001928): An abnormality of the process of blood coagulation. That is, altered ability or inability of the blood to clot. Evidence: TAS. Frequency: Frequent (HP:0040282). (ORPHA:648)
- Low posterior hairline (HP:0002162): Hair on the neck extends more inferiorly than usual. Evidence: TAS. Frequency: Frequent (HP:0040282). (ORPHA:648)
- Coarse hair (HP:0002208): Hair shafts are rough in texture. Evidence: TAS. Frequency: Frequent (HP:0040282). (ORPHA:648)
- Hepatomegaly (HP:0002240): Abnormally increased size of the liver. Evidence: TAS. Frequency: Frequent (HP:0040282). (ORPHA:648)
- Scoliosis (HP:0002650): The presence of an abnormal lateral curvature of the spine. Evidence: TAS. Frequency: Frequent (HP:0040282). (ORPHA:648)
- Delayed skeletal maturation (HP:0002750): A decreased rate of skeletal maturation. Delayed skeletal maturation can be diagnosed on the basis of an estimation of the bone age from radiographs of specific bones in the human body. Evidence: TAS. Frequency: Frequent (HP:0040282). (ORPHA:648)
- Abnormal dermatoglyphics (HP:0007477): An abnormality of dermatoglyphs (fingerprints), which are present on fingers, palms, toes, and soles. Evidence: TAS. Frequency: Frequent (HP:0040282). (ORPHA:648)
- Feeding difficulties in infancy (HP:0008872): Impaired feeding performance of an infant as manifested by difficulties such as weak and ineffective sucking, brief bursts of sucking, and falling asleep during sucking. There may be difficulties with chewing or maintaining attention. Evidence: TAS. Frequency: Frequent (HP:0040282). (ORPHA:648)
- Abnormal hair quantity (HP:0011362): An abnormal amount of hair. Evidence: TAS. Frequency: Frequent (HP:0040282). (ORPHA:648)
- Arrhythmia (HP:0011675): Any cardiac rhythm other than the normal sinus rhythm. Such a rhythm may be either of sinus or ectopic origin and either regular or irregular. An arrhythmia may be due to a disturbance in impulse formation or conduction or both. Evidence: TAS. Frequency: Frequent (HP:0040282). (ORPHA:648)
- Abnormal platelet function (HP:0011869): Any anomaly in the function of thrombocytes. Evidence: TAS. Frequency: Frequent (HP:0040282). (ORPHA:648)
- Neurodevelopmental delay (HP:0012758): Neurodevelopmental delay (NDD) refers to delays in the maturation of the brain and central nervous system; infants and young children with NDD may experience delays in the development of one or more skills including gross motor abilities, fine-motor coordination, language abilities and ability to solve increasingly complex problems. Evidence: TAS. Frequency: Frequent (HP:0040282). (ORPHA:648)
- Abnormality of the lymphatic system (HP:0100763): An anomaly of the lymphatic system, a network of lymphatic vessels that carry a clear fluid called lymph unidirectionally towards either the right lymphatic duct or the thoracic duct, which in turn drain into the right and left subclavian veins respectively. Evidence: TAS. Frequency: Frequent (HP:0040282). (ORPHA:648)
- Sensorineural hearing impairment (HP:0000407): A type of hearing impairment in one or both ears related to an abnormal functionality of the cochlear nerve. Evidence: TAS. Frequency: Occasional (HP:0040283). (ORPHA:648)
- Nystagmus (HP:0000639): Rhythmic, involuntary oscillations of one or both eyes related to abnormality in fixation, conjugate gaze, or vestibular mechanisms. Evidence: TAS. Frequency: Occasional (HP:0040283). (ORPHA:648)
- Osteopenia (HP:0000938): Osteopenia is a term to define bone density that is not normal but also not as low as osteoporosis. By definition from the World Health Organization osteopenia is defined by bone densitometry as a T score -1 to -2.5. Evidence: TAS. Frequency: Occasional (HP:0040283). (ORPHA:648)
- Bruising susceptibility (HP:0000978): An ecchymosis (bruise) refers to the skin discoloration caused by the escape of blood into the tissues from ruptured blood vessels. This term refers to an abnormally increased susceptibility to bruising. The corresponding phenotypic abnormality is generally elicited on medical history as a report of frequent ecchymoses or bruising without adequate trauma. Evidence: TAS. Frequency: Occasional (HP:0040283). (ORPHA:648)
- Melanocytic nevus (HP:0000995): A oval and round, colored (usually medium-to dark brown, reddish brown, or flesh colored) lesion. Typically, a melanocytic nevus is less than 6 mm in diameter, but may be much smaller or larger. Evidence: TAS. Frequency: Occasional (HP:0040283). (ORPHA:648)
- Lymphedema (HP:0001004): Localized fluid retention and tissue swelling caused by a compromised lymphatic system. Evidence: TAS. Frequency: Occasional (HP:0040283). (ORPHA:648)
- Brachydactyly (HP:0001156): Digits that appear disproportionately short compared to the hand/foot. The word brachydactyly is used here to describe a series distinct patterns of shortened digits (brachydactyly types A-E). This is the sense used here. Evidence: TAS. Frequency: Occasional (HP:0040283). (ORPHA:648)
- Intellectual disability (HP:0001249): The term intellectual disability or intellectual developmental disorder is used to describe significantly sub-average intellectual and adaptive functioning based on clinical assessment and as measured by individually administered, appropriately normed, standardized and validated tests of intellectual functioning and adaptive behavior, with onset during the developmental period from infancy through adolescence. Evidence: TAS. Frequency: Occasional (HP:0040283). (ORPHA:648)
- Specific learning disability (HP:0001328): Impairment of certain skills such as reading or writing, coordination, self-control, or attention that interfere with the ability to learn. The impairment is not related to a global deficiency of intelligence. Evidence: TAS. Frequency: Occasional (HP:0040283). (ORPHA:648)
- Atrial septal defect (HP:0001631): Atrial septal defect (ASD) is a congenital abnormality of the interatrial septum that enables blood flow between the left and right atria via the interatrial septum. Evidence: TAS. Frequency: Occasional (HP:0040283). (ORPHA:648)
- Hypertrophic cardiomyopathy (HP:0001639): Hypertrophic cardiomyopathy (HCM) is defined by the presence of increased ventricular wall thickness or mass in the absence of loading conditions (hypertension, valve disease) sufficient to cause the observed abnormality. Evidence: TAS. Frequency: Occasional (HP:0040283). (ORPHA:648)
- Coarctation of aorta (HP:0001680): Coarctation of the aorta is a narrowing or constriction of a segment of the aorta. Evidence: TAS. Frequency: Occasional (HP:0040283). (ORPHA:648)
- Radioulnar synostosis (HP:0002974): An abnormal osseous union (fusion) between the radius and the ulna. Evidence: TAS. Frequency: Occasional (HP:0040283). (ORPHA:648)
- Clinodactyly of the 5th finger (HP:0004209): Clinodactyly refers to a bending or curvature of the fifth finger in the radial direction (i.e., towards the 4th finger). Evidence: TAS. Frequency: Occasional (HP:0040283). (ORPHA:648)
- Postnatal growth retardation (HP:0008897): Slow or limited growth after birth. Evidence: TAS. Frequency: Occasional (HP:0040283). (ORPHA:648)
- Dilatation of the renal pelvis (HP:0010946): The presence of dilatation of the renal pelvis. Evidence: TAS. Frequency: Occasional (HP:0040283). (ORPHA:648)
- Aplasia of the semicircular canal (HP:0011381): Absence of the semicircular canal. Evidence: TAS. Frequency: Occasional (HP:0040283). (ORPHA:648)
- Juvenile myelomonocytic leukemia (HP:0012209): Juvenile myelomonocytic leukemia (JMML) is a lethal myeloproliferative disease of young childhood characterized clinically by overproduction of myelomonocytic cells and by the in vitro phenotype of hematopoietic progenitor hypersensitivity to granulocyte-macrophage colony-stimulating factor. Evidence: TAS. Frequency: Occasional (HP:0040283). (ORPHA:648)
- Delayed menarche (HP:0012569): First period after the age of 15 years. Evidence: TAS. Frequency: Occasional (HP:0040283). (ORPHA:648)
- Patent ductus arteriosus (HP:0001643): In utero, the ductus arteriosus (DA) serves to divert ventricular output away from the lungs and toward the placenta by connecting the main pulmonary artery to the descending aorta. A patent ductus arteriosus (PDA) in the first 3 days of life is a physiologic shunt in healthy term and preterm newborn infants, and normally is substantially closed within about 24 hours after bith and completely closed after about three weeks. Failure of physiologcal closure is referred to a persistent or patent ductus arteriosus (PDA). Depending on the degree of left-to-right shunting, PDA can have clinical consequences. Evidence: TAS. Frequency: Very rare (HP:0040284). (ORPHA:648)
- Hypogonadotropic hypogonadism (HP:0000044): Hypogonadotropic hypogonadism is characterized by reduced function of the gonads (testes in males or ovaries in females) and results from the absence of the gonadal stimulating pituitary hormones: follicle stimulating hormone (FSH) and luteinizing hormone (LH). Evidence: TAS. Frequency: Very frequent (HP:0040281). (ORPHA:648)
- Thick lower lip vermilion (HP:0000179): Increased thickness of the lower lip, leading to a prominent appearance of the lower lip. The height of the vermilion of the lower lip in the midline is more than 2 SD above the mean. Alternatively, an apparently increased height of the vermilion of the lower lip in the frontal view (subjective). Evidence: TAS. Frequency: Very frequent (HP:0040281). (ORPHA:648)
- High palate (HP:0000218): Height of the palate more than 2 SD above the mean (objective) or palatal height at the level of the first permanent molar more than twice the height of the teeth (subjective). Evidence: TAS. Frequency: Very frequent (HP:0040281). (ORPHA:648)
- Hypertelorism (HP:0000316): Interpupillary distance more than 2 SD above the mean (alternatively, the appearance of an increased interpupillary distance or widely spaced eyes). Evidence: TAS. Frequency: Very frequent (HP:0040281). (ORPHA:648)
- Triangular face (HP:0000325): Facial contour, as viewed from the front, triangular in shape, with breadth at the temples and tapering to a narrow chin. Evidence: TAS. Frequency: Very frequent (HP:0040281). (ORPHA:648)
- Micrognathia (HP:0000347): Developmental hypoplasia of the mandible. Evidence: TAS. Frequency: Very frequent (HP:0040281). (ORPHA:648)
- High forehead (HP:0000348): An abnormally increased height of the forehead. Evidence: TAS. Frequency: Very frequent (HP:0040281). (ORPHA:648)
- Thickened helices (HP:0000391): Increased thickness of the helix of the ear. Evidence: TAS. Frequency: Very frequent (HP:0040281). (ORPHA:648)
- Webbed neck (HP:0000465): Pterygium colli is a congenital skin fold that runs along the sides of the neck down to the shoulders. It involves an ectopic fibrotic facial band superficial to the trapezius muscle. Excess hair-bearing skin is also present and extends down the cervical region well beyond the normal hairline. Evidence: TAS. Frequency: Very frequent (HP:0040281). (ORPHA:648)
- Thickened nuchal skin fold (HP:0000474): A thickening of the skin thickness in the posterior aspect of the fetal neck. A nuchal fold (NF) measurement is obtained in a transverse section of the fetal head at the level of the cavum septum pellucidum and thalami, angled posteriorly to include the cerebellum. The measurement is taken from the outer edge of the occiput bone to the outer skin limit directly in the midline. An NF measurement greater than 5 mm at 14 to 17+6 weeks of gestation, or 6 mm at 18 to 28 weeks has been associated with a markedly increased risk for Down syndrome. Evidence: TAS. Frequency: Very frequent (HP:0040281). (ORPHA:648)
- Cystic hygroma (HP:0000476): A cystic lymphatic lesion of the neck. Evidence: TAS. Frequency: Very frequent (HP:0040281). (ORPHA:648)
- Downslanted palpebral fissures (HP:0000494): The palpebral fissure inclination is more than two standard deviations below the mean. Evidence: TAS. Frequency: Very frequent (HP:0040281). (ORPHA:648)
- Ptosis (HP:0000508): The upper eyelid margin is positioned 3 mm or more lower than usual and covers the superior portion of the iris (objective); or, the upper lid margin obscures at least part of the pupil (subjective). Evidence: TAS. Frequency: Very frequent (HP:0040281). (ORPHA:648)
- Proptosis (HP:0000520): An eye that is protruding anterior to the plane of the face to a greater extent than is typical. Evidence: TAS. Frequency: Very frequent (HP:0040281). (ORPHA:648)
- Pectus excavatum (HP:0000767): A defect of the chest wall characterized by a depression of the sternum, giving the chest ("pectus") a caved-in ("excavatum") appearance. Evidence: TAS. Frequency: Very frequent (HP:0040281). (ORPHA:648)
- Pectus carinatum (HP:0000768): A deformity of the chest caused by overgrowth of the ribs and characterized by protrusion of the sternum. Evidence: TAS. Frequency: Very frequent (HP:0040281). (ORPHA:648)
- Dysarthria (HP:0001260): Dysarthric speech is a general description referring to a neurological speech disorder characterized by poor articulation. Depending on the involved neurological structures, dysarthria may be further classified as spastic, flaccid, ataxic, hyperkinetic and hypokinetic, or mixed. Evidence: TAS. Frequency: Very frequent (HP:0040281). (ORPHA:648)
- Muscle weakness (HP:0001324): Reduced strength of muscles. Evidence: TAS. Frequency: Very frequent (HP:0040281). (ORPHA:648)
- Abnormal speech pattern (HP:0002167): An abnormality in the sound (volume) or cadence (rate) of speech. Evidence: TAS. Frequency: Very frequent (HP:0040281). (ORPHA:648)
- Abnormal EKG (HP:0003115): Abnormal rhythm of the heart. Evidence: TAS. Frequency: Very frequent (HP:0040281). (ORPHA:648)
- Short stature (HP:0004322): A height below that which is expected according to age and gender norms. Although there is no universally accepted definition of short stature, many refer to "short stature" as height more than 2 standard deviations below the mean for age and gender (or below the 3rd percentile for age and gender dependent norms). Evidence: TAS. Frequency: Very frequent (HP:0040281). (ORPHA:648)
- Pulmonary artery stenosis (HP:0004415): An abnormal narrowing or constriction of the pulmonary artery, in the main pulmonary artery and/or in the left or right pulmonary artery branches. Evidence: TAS. Frequency: Very frequent (HP:0040281). (ORPHA:648)
- Wide intermamillary distance (HP:0006610): A larger than usual distance between the left and right nipple. Evidence: TAS. Frequency: Very frequent (HP:0040281). (ORPHA:648)
- Aplasia/Hypoplasia of the abdominal wall musculature (HP:0010318): Absence or underdevelopment of the abdominal musculature. Evidence: TAS. Frequency: Very frequent (HP:0040281). (ORPHA:648)
- Midface retrusion (HP:0011800): Posterior positions and/or vertical shortening of the infraorbital and perialar regions, or increased concavity of the face and/or reduced nasolabial angle. Evidence: TAS. Frequency: Very frequent (HP:0040281). (ORPHA:648)
- Abnormal cardiovascular system morphology (HP:0030680): Any structural anomaly of the heart and blood vessels. Evidence: TAS. Frequency: Very frequent (HP:0040281). (ORPHA:648)
- Enlarged thorax (HP:0100625). Evidence: TAS. Frequency: Very frequent (HP:0040281). (ORPHA:648)
- Cryptorchidism (HP:0000028): Testis in inguinal canal. That is, absence of one or both testes from the scrotum owing to failure of the testis or testes to descend through the inguinal canal to the scrotum. Evidence: TAS. Frequency: Frequent (HP:0040282). (ORPHA:648)
- Abnormality of the genital system (HP:0000078): An abnormality of the genital system. Evidence: TAS. Frequency: Frequent (HP:0040282). (ORPHA:648)
- Strabismus (HP:0000486): A misalignment of the eyes so that the visual axes deviate from bifoveal fixation. The classification of strabismus may be based on a number of features including the relative position of the eyes, whether the deviation is latent or manifest, intermittent or constant, concomitant or otherwise and according to the age of onset and the relevance of any associated refractive error. Evidence: TAS. Frequency: Frequent (HP:0040282). (ORPHA:648)
- Blue irides (HP:0000635): A markedly blue coloration of the iris. Evidence: TAS. Frequency: Frequent (HP:0040282). (ORPHA:648)
- Hypotonia (HP:0001252): Hypotonia is an abnormally low muscle tone (the amount of tension or resistance to movement in a muscle). Even when relaxed, muscles have a continuous and passive partial contraction which provides some resistance to passive stretching. Hypotonia thus manifests as diminished resistance to passive stretching. Hypotonia is not the same as muscle weakness, although the two conditions can co-exist. Evidence: TAS. Frequency: Frequent (HP:0040282). (ORPHA:648)
- Posteriorly rotated ears (HP:0000358): A type of abnormal location of the ears in which the position of the ears is characterized by posterior rotation (the superior part of the ears is rotated towards the back of the head, and the inferior part of the ears towards the front). Evidence: TAS. Frequency: Very frequent (HP:0040281). (ORPHA:648)